Phenotypes associated with the disease autosomal dominant nonsyndromic hearing loss 41 (OMIM:608224):
- Juvenile onset (HP:0003621): Onset of signs or symptoms of disease between the age of 5 and 15 years. Evidence: PCS. (PMID:23345450)
- Early young adult onset (HP:0025708): Onset of disease at an age of greater than or equal to 16 to under 19 years. Evidence: PCS. (PMID:23345450)
- Progressive sensorineural hearing impairment (HP:0000408): A progressive form of sensorineural hearing impairment. Evidence: PCS. (PMID:23345450)
- Tinnitus (HP:0000360): Tinnitus is an auditory perception that can be described as the experience of sound, in the ear or in the head, in the absence of external acoustic stimulation. Evidence: PCS. (PMID:23345450)
- Autosomal dominant inheritance (HP:0000006): A mode of inheritance that is observed for traits related to a gene encoded on one of the autosomes (i.e., the human chromosomes 1-22) in which a trait manifests in heterozygotes. In the context of medical genetics, an autosomal dominant disorder is caused when a single copy of the mutant allele is present. Males and females are affected equally, and can both transmit the disorder with a risk of 50% for each child of inheriting the mutant allele. Evidence: PCS. (PMID:23345450)